Phenotypes associated with the disease 3q29 microduplication syndrome (ORPHA:251038):
- Abnormality of the dentition (HP:0000164): Any abnormality of the teeth. Evidence: TAS. Frequency: Frequent (HP:0040282). (ORPHA:251038)
- Cleft palate (HP:0000175): Cleft palate is a developmental defect of the palate resulting from a failure of fusion of the palatine processes and manifesting as a separation of the roof of the mouth (soft and hard palate). Evidence: TAS. Frequency: Occasional (HP:0040283). (ORPHA:251038)
- High palate (HP:0000218): Height of the palate more than 2 SD above the mean (objective) or palatal height at the level of the first permanent molar more than twice the height of the teeth (subjective). Evidence: TAS. Frequency: Occasional (HP:0040283). (ORPHA:251038)
- Large fontanelles (HP:0000239): In newborns, the two frontal bones, two parietal bones, and one occipital bone are joined by fibrous sutures, which form a small posterior fontanelle, and a larger, diamond-shaped anterior fontanelle. These regions allow for the skull to pass the birth canal and for later growth. The fontanelles gradually ossify, whereby the posterior fontanelle usually closes by eight weeks and the anterior fontanelle by the 9th to 16th month of age. Large fontanelles are diagnosed if the fontanelles are larger than age-dependent norms. Evidence: TAS. Frequency: Occasional (HP:0040283). (ORPHA:251038)
- Microcephaly (HP:0000252): Head circumference below 2 standard deviations below the mean for age and gender. Evidence: TAS. Frequency: Frequent (HP:0040282). (ORPHA:251038)
- Macrocephaly (HP:0000256): Occipitofrontal (head) circumference greater than 97th centile compared to appropriate, age matched, sex-matched normal standards. Alternatively, a apparently increased size of the cranium. Evidence: TAS. Frequency: Occasional (HP:0040283). (ORPHA:251038)
- High forehead (HP:0000348): An abnormally increased height of the forehead. Evidence: TAS. Frequency: Occasional (HP:0040283). (ORPHA:251038)
- Hearing impairment (HP:0000365): A decreased magnitude of the sensory perception of sound. Evidence: TAS. Frequency: Occasional (HP:0040283). (ORPHA:251038)
- Low-set ears (HP:0000369): Upper insertion of the ear to the scalp below an imaginary horizontal line drawn between the inner canthi of the eye and extending posteriorly to the ear. Evidence: TAS. Frequency: Occasional (HP:0040283). (ORPHA:251038)
- Wide nasal bridge (HP:0000431): Increased breadth of the nasal bridge (and with it, the nasal root). Evidence: TAS. Frequency: Occasional (HP:0040283). (ORPHA:251038)
- Short neck (HP:0000470): Diminished length of the neck. Evidence: TAS. Frequency: Occasional (HP:0040283). (ORPHA:251038)
- Downslanted palpebral fissures (HP:0000494): The palpebral fissure inclination is more than two standard deviations below the mean. Evidence: TAS. Frequency: Frequent (HP:0040282). (ORPHA:251038)
- Cataract (HP:0000518): A cataract is an opacity or clouding that develops in the crystalline lens of the eye or in its capsule. Evidence: TAS. Frequency: Occasional (HP:0040283). (ORPHA:251038)
- Aniridia (HP:0000526): Abnormality of the iris characterized by, typically bilateral, complete or partial iris hypoplasia. The phenotype ranges from mild defects of anterior iris stroma only to almost complete absence of the iris. Evidence: TAS. Frequency: Occasional (HP:0040283). (ORPHA:251038)
- Microphthalmia (HP:0000568): A developmental anomaly characterized by abnormal smallness of one or both eyes. Evidence: TAS. Frequency: Occasional (HP:0040283). (ORPHA:251038)
- Iris coloboma (HP:0000612): A coloboma of the iris. Evidence: TAS. Frequency: Occasional (HP:0040283). (ORPHA:251038)
- Sclerocornea (HP:0000647): A congenital anomaly in which a part or the whole of the cornea acquires the characteristics of sclera, resulting in clouding of the cornea. Evidence: TAS. Frequency: Occasional (HP:0040283). (ORPHA:251038)
- Intellectual disability (HP:0001249): The term intellectual disability or intellectual developmental disorder is used to describe significantly sub-average intellectual and adaptive functioning based on clinical assessment and as measured by individually administered, appropriately normed, standardized and validated tests of intellectual functioning and adaptive behavior, with onset during the developmental period from infancy through adolescence. Evidence: TAS. Frequency: Frequent (HP:0040282). (ORPHA:251038)
- Seizure (HP:0001250): A seizure is an intermittent abnormality of nervous system physiology characterized by a transient occurrence of signs and/or symptoms due to abnormal excessive or synchronous neuronal activity in the brain. Evidence: TAS. Frequency: Occasional (HP:0040283). (ORPHA:251038)
- Hypotonia (HP:0001252): Hypotonia is an abnormally low muscle tone (the amount of tension or resistance to movement in a muscle). Even when relaxed, muscles have a continuous and passive partial contraction which provides some resistance to passive stretching. Hypotonia thus manifests as diminished resistance to passive stretching. Hypotonia is not the same as muscle weakness, although the two conditions can co-exist. Evidence: TAS. Frequency: Frequent (HP:0040282). (ORPHA:251038)
- Global developmental delay (HP:0001263): A delay in the achievement of motor or mental milestones in the domains of development of a child, including motor skills, speech and language, cognitive skills, and social and emotional skills. This term should only be used to describe children younger than five years of age. Evidence: TAS. Frequency: Frequent (HP:0040282). (ORPHA:251038)
- Craniosynostosis (HP:0001363): Craniosynostosis refers to the premature closure of the cranial sutures. Primary craniosynostosis refers to the closure of one or more sutures due to abnormalities in skull development, and secondary craniosynostosis results from failure of brain growth. Evidence: TAS. Frequency: Occasional (HP:0040283). (ORPHA:251038)
- Obesity (HP:0001513): Accumulation of substantial excess body fat. Evidence: TAS. Frequency: Frequent (HP:0040282). (ORPHA:251038)
- Ventricular septal defect (HP:0001629): A hole between the two bottom chambers (ventricles) of the heart. The defect is centered around the most superior aspect of the ventricular septum. Evidence: TAS. Frequency: Occasional (HP:0040283). (ORPHA:251038)
- Toe syndactyly (HP:0001770): Webbing or fusion of the toes, involving soft parts only or including bone structure. Bony fusions are referred to as "bony" Syndactyly if the fusion occurs in a radio-ulnar axis. Fusions of bones of the toes in a proximo-distal axis are referred to as "Symphalangism". Evidence: TAS. Frequency: Occasional (HP:0040283). (ORPHA:251038)
- Camptodactyly of toe (HP:0001836): Camptodactyly is a painless flexion contracture of the proximal interphalangeal (PIP) joint that is usually gradually progressive. This term refers to camptodactyly of one or more toes. Evidence: TAS. Frequency: Occasional (HP:0040283). (ORPHA:251038)
- Sandal gap (HP:0001852): A widely spaced gap between the first toe (the great toe) and the second toe. Evidence: TAS. Frequency: Occasional (HP:0040283). (ORPHA:251038)
- Deep philtrum (HP:0002002): Accentuated, prominent philtral ridges giving rise to an exaggerated groove in the midline between the nasal base and upper vermillion border. Evidence: TAS. Frequency: Occasional (HP:0040283). (ORPHA:251038)
- Ectopic anus (HP:0004397): Abnormal displacement or malposition of the anus. Evidence: TAS. Frequency: Occasional (HP:0040283). (ORPHA:251038)
- Biparietal narrowing (HP:0004422): A narrowing of the biparietal diameter (i.e., of the transverse distance between the protuberances of the two parietal bones of the skull). Evidence: TAS. Frequency: Occasional (HP:0040283). (ORPHA:251038)